Phenotypes associated with the disease Interstitial granulomatous dermatitis with arthritis (ORPHA:79099):
- Rheumatoid arthritis (HP:0001370): Inflammatory changes in the synovial membranes and articular structures with widespread fibrinoid degeneration of the collagen fibers in mesenchymal tissues, as well as atrophy and rarefaction of bony structures. Evidence: TAS. Frequency: Obligate (HP:0040280). (ORPHA:79099)
- Erythema (HP:0010783): Redness of the skin, caused by hyperemia of the capillaries in the lower layers of the skin. Evidence: TAS. Frequency: Obligate (HP:0040280). (ORPHA:79099)
- Elevated erythrocyte sedimentation rate (HP:0003565): An increased erythrocyte sedimentation rate (ESR). The ESR is a test that measures the distance that erythrocytes have fallen after one hour in a vertical column of anticoagulated blood under the influence of gravity. The ESR is a nonspecific finding. An elevation may indicate inflammation or may be caused by any condition that elevates fibrinogen. Evidence: TAS. Frequency: Very frequent (HP:0040281). (ORPHA:79099)
- Inflammatory abnormality of the skin (HP:0011123): The presence of inflammation of the skin. That is, an abnormality of the skin resulting from the local accumulation of fluid, plasma proteins, and leukocytes. Evidence: TAS. Frequency: Very frequent (HP:0040281). (ORPHA:79099)
- Elevated circulating C-reactive protein concentration (HP:0011227): The concentration of C-reactive protein in the blood circulation is above the upper limit of normal. Evidence: TAS. Frequency: Very frequent (HP:0040281). (ORPHA:79099)
- Papule (HP:0200034): A circumscribed, solid elevation of skin with no visible fluid, varying in size from a pinhead to less than 10mm in diameter at the widest point. Evidence: TAS. Frequency: Very frequent (HP:0040281). (ORPHA:79099)
- Rheumatoid factor positive (HP:0002923): The presence in the serum of an autoantibody directed against the Fc portion of IgG. Evidence: TAS. Frequency: Frequent (HP:0040282). (ORPHA:79099)
- Pruritus (HP:0000989): Pruritus is an itch or a sensation that makes a person want to scratch. This term refers to an abnormally increased disposition to experience pruritus. Evidence: TAS. Frequency: Occasional (HP:0040283). (ORPHA:79099)